- Abnormal vestibular function (HP:0001751): An abnormality of the functioning of the vestibular apparatus. Evidence: PCS. Frequency: 0/28. (PMID:29860631)
- Sensorineural hearing impairment (HP:0000407): A type of hearing impairment in one or both ears related to an abnormal functionality of the cochlear nerve. Evidence: PCS. Frequency: 28/28. (PMID:29860631)
- Adult onset (HP:0003581): Onset of disease manifestations in adulthood, defined here as at the age of 16 years or later. Evidence: PCS. (PMID:29860631)
- Autosomal dominant inheritance (HP:0000006): A mode of inheritance that is observed for traits related to a gene encoded on one of the autosomes (i.e., the human chromosomes 1-22) in which a trait manifests in heterozygotes. In the context of medical genetics, an autosomal dominant disorder is caused when a single copy of the mutant allele is present. Males and females are affected equally, and can both transmit the disorder with a risk of 50% for each child of inheriting the mutant allele. Evidence: PCS. (PMID:29860631)
These phenotypes are associated with the disease hearing loss, autosomal dominant 74 (OMIM:618140).